Phenotypes associated with the disease MOMO syndrome (ORPHA:2563):
- Obesity (HP:0001513): Accumulation of substantial excess body fat. Evidence: TAS. Frequency: Obligate (HP:0040280). (ORPHA:2563)
- Thick lower lip vermilion (HP:0000179): Increased thickness of the lower lip, leading to a prominent appearance of the lower lip. The height of the vermilion of the lower lip in the midline is more than 2 SD above the mean. Alternatively, an apparently increased height of the vermilion of the lower lip in the frontal view (subjective). Evidence: TAS. Frequency: Frequent (HP:0040282). (ORPHA:2563)
- Thick upper lip vermilion (HP:0000215): Height of the vermilion of the upper lip in the midline more than 2 SD above the mean. Alternatively, an apparently increased height of the vermilion of the upper lip in the frontal view (subjective). Evidence: TAS. Frequency: Frequent (HP:0040282). (ORPHA:2563)
- High palate (HP:0000218): Height of the palate more than 2 SD above the mean (objective) or palatal height at the level of the first permanent molar more than twice the height of the teeth (subjective). Evidence: TAS. Frequency: Frequent (HP:0040282). (ORPHA:2563)
- Brachycephaly (HP:0000248): An abnormality of skull shape characterized by a decreased anterior-posterior diameter. That is, a cephalic index greater than 81%. Alternatively, an apparently shortened anteroposterior dimension (length) of the head compared to width. Evidence: TAS. Frequency: Frequent (HP:0040282). (ORPHA:2563)
- Macrocephaly (HP:0000256): Occipitofrontal (head) circumference greater than 97th centile compared to appropriate, age matched, sex-matched normal standards. Alternatively, a apparently increased size of the cranium. Evidence: TAS. Frequency: Frequent (HP:0040282). (ORPHA:2563)
- Epicanthus (HP:0000286): A fold of skin starting above the medial aspect of the upper eyelid and arching downward to cover, pass in front of and lateral to the medial canthus. Evidence: TAS. Frequency: Frequent (HP:0040282). (ORPHA:2563)
- Hypertelorism (HP:0000316): Interpupillary distance more than 2 SD above the mean (alternatively, the appearance of an increased interpupillary distance or widely spaced eyes). Evidence: TAS. Frequency: Frequent (HP:0040282). (ORPHA:2563)
- Smooth philtrum (HP:0000319): Flat skin surface, with no ridge formation in the central region of the upper lip between the nasal base and upper vermilion border. Evidence: TAS. Frequency: Frequent (HP:0040282). (ORPHA:2563)
- Broad forehead (HP:0000337): Width of the forehead or distance between the frontotemporales is more than two standard deviations above the mean (objective); or apparently increased distance between the two sides of the forehead. Evidence: TAS. Frequency: Frequent (HP:0040282). (ORPHA:2563)
- Long philtrum (HP:0000343): Distance between nasal base and midline upper lip vermilion border more than 2 SD above the mean. Alternatively, an apparently increased distance between nasal base and midline upper lip vermilion border. Evidence: TAS. Frequency: Frequent (HP:0040282). (ORPHA:2563)
- High forehead (HP:0000348): An abnormally increased height of the forehead. Evidence: TAS. Frequency: Frequent (HP:0040282). (ORPHA:2563)
- Short neck (HP:0000470): Diminished length of the neck. Evidence: TAS. Frequency: Frequent (HP:0040282). (ORPHA:2563)
- Strabismus (HP:0000486): A misalignment of the eyes so that the visual axes deviate from bifoveal fixation. The classification of strabismus may be based on a number of features including the relative position of the eyes, whether the deviation is latent or manifest, intermittent or constant, concomitant or otherwise and according to the age of onset and the relevance of any associated refractive error. Evidence: TAS. Frequency: Frequent (HP:0040282). (ORPHA:2563)
- Downslanted palpebral fissures (HP:0000494): The palpebral fissure inclination is more than two standard deviations below the mean. Evidence: TAS. Frequency: Frequent (HP:0040282). (ORPHA:2563)
- Glaucoma (HP:0000501): Glaucoma refers loss of retinal ganglion cells in a characteristic pattern of optic neuropathy usually associated with increased intraocular pressure. Evidence: TAS. Frequency: Frequent (HP:0040282). (ORPHA:2563)
- Chorioretinal coloboma (HP:0000567): Absence of a region of the retina, retinal pigment epithelium, and choroid. Evidence: TAS. Frequency: Frequent (HP:0040282). (ORPHA:2563)
- Eyelid coloboma (HP:0000625): A short discontinuity of the margin of the lower or upper eyelid. Evidence: TAS. Frequency: Frequent (HP:0040282). (ORPHA:2563)
- Nystagmus (HP:0000639): Rhythmic, involuntary oscillations of one or both eyes related to abnormality in fixation, conjugate gaze, or vestibular mechanisms. Evidence: TAS. Frequency: Frequent (HP:0040282). (ORPHA:2563)
- Taurodontia (HP:0000679): Increased volume of dental pulp of permanent molar characterized by a crown body-root ratio equal or larger than 1:1 or an elongated pulp chambers and apical displacement of the bifurcation or trifurcation of the roots. Evidence: TAS. Frequency: Frequent (HP:0040282). (ORPHA:2563)
- Delayed eruption of teeth (HP:0000684): Delayed tooth eruption, which can be defined as tooth eruption more than 2 SD beyond the mean eruption age. Evidence: TAS. Frequency: Frequent (HP:0040282). (ORPHA:2563)
- Dental malocclusion (HP:0000689): Dental malocclusion refers to an abnormality of the occlusion, or alignment, of the teeth and the way the upper and lower teeth fit together, resulting in overcrowding of teeth or in abnormal bite patterns. Evidence: TAS. Frequency: Frequent (HP:0040282). (ORPHA:2563)
- Short sternum (HP:0000879): Decreased inferosuperior length of the sternum. Evidence: TAS. Frequency: Frequent (HP:0040282). (ORPHA:2563)
- Cutis marmorata (HP:0000965): A reticular discoloration of the skin with cyanotic (reddish-blue appearing) areas surrounding pale central areas due to dilation of capillary blood vessels and stagnation of blood within the vessels. Cutis marmorata generally occurs on the legs, arms and trunk and is often more severe in cold weather. Evidence: TAS. Frequency: Frequent (HP:0040282). (ORPHA:2563)
- Large hands (HP:0001176). Evidence: TAS. Frequency: Frequent (HP:0040282). (ORPHA:2563)
- Intellectual disability (HP:0001249): The term intellectual disability or intellectual developmental disorder is used to describe significantly sub-average intellectual and adaptive functioning based on clinical assessment and as measured by individually administered, appropriately normed, standardized and validated tests of intellectual functioning and adaptive behavior, with onset during the developmental period from infancy through adolescence. Evidence: TAS. Frequency: Frequent (HP:0040282). (ORPHA:2563)
- Seizure (HP:0001250): A seizure is an intermittent abnormality of nervous system physiology characterized by a transient occurrence of signs and/or symptoms due to abnormal excessive or synchronous neuronal activity in the brain. Evidence: TAS. Frequency: Frequent (HP:0040282). (ORPHA:2563)
- Large for gestational age (HP:0001520): The term large for gestational age applies to babies whose birth weight lies above the 90th percentile for that gestational age. Evidence: TAS. Frequency: Frequent (HP:0040282). (ORPHA:2563)
- Overgrowth (HP:0001548): Excessive postnatal growth which may comprise increased weight, increased length, and/or increased head circumference. Evidence: TAS. Frequency: Frequent (HP:0040282). (ORPHA:2563)
- Hyperconvex nail (HP:0001795): When viewed on end (with the digit tip pointing toward the examiner's eye) the curve of the nail forms a tighter curve of convexity. Evidence: TAS. Frequency: Frequent (HP:0040282). (ORPHA:2563)
- Long foot (HP:0001833): Increased back to front length of the foot. Evidence: TAS. Frequency: Frequent (HP:0040282). (ORPHA:2563)
- Frontal bossing (HP:0002007): Bilateral bulging of the lateral frontal bone prominences with relative sparing of the midline. Evidence: TAS. Frequency: Frequent (HP:0040282). (ORPHA:2563)
- Femoral bowing (HP:0002980): Bowing (abnormal curvature) of the femur. Evidence: TAS. Frequency: Frequent (HP:0040282). (ORPHA:2563)
- Short stature (HP:0004322): A height below that which is expected according to age and gender norms. Although there is no universally accepted definition of short stature, many refer to "short stature" as height more than 2 standard deviations below the mean for age and gender (or below the 3rd percentile for age and gender dependent norms). Evidence: TAS. Frequency: Frequent (HP:0040282). (ORPHA:2563)
- Bilateral microphthalmos (HP:0007633): A developmental anomaly characterized by abnormal smallness of both eyes. Evidence: TAS. Frequency: Frequent (HP:0040282). (ORPHA:2563)
- Underfolded helix (HP:0008577): Underdevelopment of the helix that either affects the entire helix, or is localized. Evidence: TAS. Frequency: Frequent (HP:0040282). (ORPHA:2563)
- Abnormal bone ossification (HP:0011849): Any anomaly in the formation of bone or of a bony substance, or the conversion of fibrous tissue or of cartilage into bone or a bony substance. Evidence: TAS. Frequency: Frequent (HP:0040282). (ORPHA:2563)
- Wide nasal base (HP:0012810): Increased distance between the attachments of the alae nasi to the face. Evidence: TAS. Frequency: Frequent (HP:0040282). (ORPHA:2563)
- Auditory sensitivity (HP:0025112): Decreased tolerance to sound. Evidence: TAS. Frequency: Frequent (HP:0040282). (ORPHA:2563)
- Tall stature (HP:0000098): A height above that which is expected according to age and gender norms. Evidence: TAS. Frequency: Occasional (HP:0040283). (ORPHA:2563)
- Blindness (HP:0000618): Blindness is the condition of lacking visual perception defined as a profound reduction in visual perception. On the 6m visual acuity scale, blindness is defined as less than 3/60. On the 20ft visual acuity scale, blindness is defined as less than 20/400. On the decimal visual acuity scale, blindness is defined as less than 0.05. Blindness is typically characterized by a visual field of no greater than 10 degrees in radius around central fixation. Evidence: TAS. Frequency: Occasional (HP:0040283). (ORPHA:2563)
- Autism (HP:0000717): Autism is a neurodevelopmental disorder characterized by impaired social interaction and communication, and by restricted and repetitive behavior. Autism begins in childhood. It is marked by the presence of markedly abnormal or impaired development in social interaction and communication and a markedly restricted repertoire of activity and interest. Manifestations of the disorder vary greatly depending on the developmental level and chronological age of the individual (DSM-IV). Evidence: TAS. Frequency: Occasional (HP:0040283). (ORPHA:2563)
- Congenital pseudoarthrosis of the clavicle (HP:0006585): The two portions of the clavicle (corresponding to the two primary ossification centers of the clavicle) are connected by a fibrous bridge that is contiguous with the periosteum, and a synovial membrane develops, resulting in a clavicle with a bipartite appearance radiographically. Congenital pseudarthrosis of the clavicle generally presents as a painless mass or swelling over the clavicle. Evidence: TAS. Frequency: Occasional (HP:0040283). (ORPHA:2563)
Not associated with this disease:
- Abnormality of the thyroid gland (HP:0000820): An abnormality of the thyroid gland. Evidence: TAS. (ORPHA:2563)